Phenotypes associated with the disease Congenital muscular dystrophy with intellectual disability (ORPHA:370968):
- Intellectual disability (HP:0001249): The term intellectual disability or intellectual developmental disorder is used to describe significantly sub-average intellectual and adaptive functioning based on clinical assessment and as measured by individually administered, appropriately normed, standardized and validated tests of intellectual functioning and adaptive behavior, with onset during the developmental period from infancy through adolescence. Evidence: TAS. Frequency: Very frequent (HP:0040281). (ORPHA:370968)
- Elevated circulating creatine kinase activity (HP:0003236): The activity of creatine kinase in the blood circulation is above the upper limit of normal. Evidence: TAS. Frequency: Very frequent (HP:0040281). (ORPHA:370968)
- Floppy infant (HP:0008947): Floppiness/hypotonia is defined as reduced resistance to passive movement of joints. Physical examination of floppy/hypotonic infants shows head lag, lack of shoulder and elbow muscle contraction on traction response, inability to tighten the shoulder girdle muscles (or slipping through) when held under the axillae, scarf sign (when the arm is pulled to the opposite side, the arm wraps around the neck with the elbow crossing midline), hyperdorsiflexion of the feet, easy apposition of the thumb against the forearm, feet touching the cheek with ease and without discomfort, frog leg position, and inverted U sign on ventral suspension (head, arms, and legs hanging down without elbow or knee flexion and the trunk rounded in a dome shape). Evidence: TAS. Frequency: Very frequent (HP:0040281). (ORPHA:370968)
- Hypoglycosylation of alpha-dystroglycan (HP:0030046): A reduction in the degree of glycosylation of alpha-dystroglycan in muscle tissue. Evidence: TAS. Frequency: Very frequent (HP:0040281). (ORPHA:370968)
- Reduced muscle fiber alpha dystroglycan (HP:0030099): Immunohistochemistry reveals reduced alpha dystroglycan protein in the muscle biopsy. Alpha-dystroglycan is a heavily glycosylated peripheral-membrane component of the dystrophin-associated glycoprotein complex (DAPC), which, in addition to laminin alpha2, binds perlecan and agrin in the extracellular matrix, whereas beta-dystroglycan, derived from the same gene, is a transmembrane protein that links to dystrophin intracellularly. Evidence: TAS. Frequency: Very frequent (HP:0040281). (ORPHA:370968)
- Microcephaly (HP:0000252): Head circumference below 2 standard deviations below the mean for age and gender. Evidence: TAS. Frequency: Frequent (HP:0040282). (ORPHA:370968)
- Global developmental delay (HP:0001263): A delay in the achievement of motor or mental milestones in the domains of development of a child, including motor skills, speech and language, cognitive skills, and social and emotional skills. This term should only be used to describe children younger than five years of age. Evidence: TAS. Frequency: Frequent (HP:0040282). (ORPHA:370968)
- Motor delay (HP:0001270): A type of Developmental delay characterized by a delay in acquiring motor skills. Evidence: TAS. Frequency: Frequent (HP:0040282). (ORPHA:370968)
- Cerebral cortical atrophy (HP:0002120): Atrophy of the cortex of the cerebrum. Evidence: TAS. Frequency: Frequent (HP:0040282). (ORPHA:370968)
- Multiple joint contractures (HP:0002828). Evidence: TAS. Frequency: Frequent (HP:0040282). (ORPHA:370968)
- Limb-girdle muscle weakness (HP:0003325): Weakness of the limb-girdle muscles (also known as the pelvic and shoulder girdles), that is, lack of strength of the muscles around the shoulders and the pelvis. Evidence: TAS. Frequency: Frequent (HP:0040282). (ORPHA:370968)
- Poor gross motor coordination (HP:0007015): An abnormality of the ability (skills) to perform a precise movement of large muscles with the intent to perform a specific act. Gross motor skills are required to mediate movements of the arms, legs, and other large body parts. Evidence: TAS. Frequency: Frequent (HP:0040282). (ORPHA:370968)
- Calf muscle hypertrophy (HP:0008981): Muscle hypertrophy affecting the calf muscles. Evidence: TAS. Frequency: Frequent (HP:0040282). (ORPHA:370968)
- Feeding difficulties (HP:0011968): Impaired ability to eat related to problems gathering food and getting ready to suck, chew, or swallow it. Evidence: TAS. Frequency: Frequent (HP:0040282). (ORPHA:370968)
- Fatigable weakness of skeletal muscles (HP:0030197): A type of weakness of skeletal muscle that occurs after a muscle group is used and lessens if the muscle group has some rest. That is, there is diminution of strength with repetitive muscle actions. Evidence: TAS. Frequency: Frequent (HP:0040282). (ORPHA:370968)
- Cryptorchidism (HP:0000028): Testis in inguinal canal. That is, absence of one or both testes from the scrotum owing to failure of the testis or testes to descend through the inguinal canal to the scrotum. Evidence: TAS. Frequency: Occasional (HP:0040283). (ORPHA:370968)
- Micropenis (HP:0000054): Abnormally small penis. At birth, the normal penis is about 3 cm (stretched length from pubic tubercle to tip of penis) with micropenis less than 2.0-2.5 cm. Evidence: TAS. Frequency: Occasional (HP:0040283). (ORPHA:370968)
- Abnormality of the eye (HP:0000478): Any abnormality of the eye, including location, spacing, and intraocular abnormalities. Evidence: TAS. Frequency: Occasional (HP:0040283). (ORPHA:370968)
- Strabismus (HP:0000486): A misalignment of the eyes so that the visual axes deviate from bifoveal fixation. The classification of strabismus may be based on a number of features including the relative position of the eyes, whether the deviation is latent or manifest, intermittent or constant, concomitant or otherwise and according to the age of onset and the relevance of any associated refractive error. Evidence: TAS. Frequency: Occasional (HP:0040283). (ORPHA:370968)
- Myopia (HP:0000545): An abnormality of refraction characterized by the ability to see objects nearby clearly, while objects in the distance appear blurry. Evidence: TAS. Frequency: Occasional (HP:0040283). (ORPHA:370968)
- Pigmentary retinopathy (HP:0000580): An abnormality of the retina characterized by pigment deposition. It is typically associated with migration and proliferation of macrophages or retinal pigment epithelial cells into the retina; melanin from these cells causes the pigmentary changes. Pigmentary retinopathy is a common final pathway of many retinal conditions and is often associated with visual loss. Evidence: TAS. Frequency: Occasional (HP:0040283). (ORPHA:370968)
- Abnormality of the nervous system (HP:0000707): An abnormality of the nervous system. Evidence: TAS. Frequency: Occasional (HP:0040283). (ORPHA:370968)
- Diminished deep tendon reflex (HP:0001315): A reduction (hyporeflexia) or complete absence (areflexia) of the involuntary muscle contraction normally elicited by a reflex stimulus, such as tapping a deep tendon. Evidence: TAS. Frequency: Occasional (HP:0040283). (ORPHA:370968)
- Cerebellar vermis hypoplasia (HP:0001320): Underdevelopment of the vermis of cerebellum. Evidence: TAS. Frequency: Occasional (HP:0040283). (ORPHA:370968)
- Cerebellar hypoplasia (HP:0001321): Cerebellar hypoplasia is a descriptive term implying a cerebellum with a reduced volume, but a normal shape and is stable over time. Evidence: TAS. Frequency: Occasional (HP:0040283). (ORPHA:370968)
- Hypoplasia of the corpus callosum (HP:0002079): Underdevelopment of the corpus callosum. Evidence: TAS. Frequency: Occasional (HP:0040283). (ORPHA:370968)
- Respiratory insufficiency (HP:0002093). Evidence: TAS. Frequency: Occasional (HP:0040283). (ORPHA:370968)
- Ventriculomegaly (HP:0002119): An increase in size of the ventricular system of the brain. Evidence: TAS. Frequency: Occasional (HP:0040283). (ORPHA:370968)
- Poor speech (HP:0002465). Evidence: TAS. Frequency: Occasional (HP:0040283). (ORPHA:370968)
- Loss of ambulation (HP:0002505): Inability to walk in a person who previous had the ability to walk. Evidence: TAS. Frequency: Occasional (HP:0040283). (ORPHA:370968)
- Abnormal periventricular white matter morphology (HP:0002518): A structural abnormality of the myelinated axons (white matter) located near the cerebral ventricles. Evidence: TAS. Frequency: Occasional (HP:0040283). (ORPHA:370968)
- Scoliosis (HP:0002650): The presence of an abnormal lateral curvature of the spine. Evidence: TAS. Frequency: Occasional (HP:0040283). (ORPHA:370968)
- Hip dislocation (HP:0002827): Displacement of the femur from its normal location in the hip joint. Evidence: TAS. Frequency: Occasional (HP:0040283). (ORPHA:370968)
- Respiratory failure (HP:0002878): A severe form of respiratory insufficiency characterized by inadequate gas exchange such that the levels of oxygen or carbon dioxide cannot be maintained within normal limits. Evidence: TAS. Frequency: Occasional (HP:0040283). (ORPHA:370968)
- Axial muscle weakness (HP:0003327): Reduced strength of the axial musculature (i.e., of the muscles of the head and neck, spine, and ribs). Evidence: TAS. Frequency: Occasional (HP:0040283). (ORPHA:370968)
- Abnormality of connective tissue (HP:0003549): Any abnormality of the soft tissues, including both connective tissue (tendons, ligaments, fascia, fibrous tissues, and fat). Evidence: TAS. Frequency: Occasional (HP:0040283). (ORPHA:370968)
- Skeletal muscle hypertrophy (HP:0003712): Abnormal increase in muscle size and mass not due to training. Evidence: TAS. Frequency: Occasional (HP:0040283). (ORPHA:370968)
- Decreased cervical spine mobility (HP:0004637). Evidence: TAS. Frequency: Occasional (HP:0040283). (ORPHA:370968)
- Abnormal pons morphology (HP:0007361): A structural abnormality of the pons. Evidence: TAS. Frequency: Occasional (HP:0040283). (ORPHA:370968)
- Neuropathic spinal arthropathy (HP:0008443): A progressive disorder of vertebral joint degeneration that occurs in the setting of any condition characterized by decreased afferent innervation, involving loss of deep pain and proprioceptive sensation in the vertebral column. Patients most commonly present with symptoms of lower back pain, sitting imbalance, progressive spinal deformity (usually kyphosis), and an audible clicking sound on changing postures. Evidence: TAS. Frequency: Occasional (HP:0040283). (ORPHA:370968)
- Facial palsy (HP:0010628): Facial nerve palsy is a dysfunction of cranial nerve VII (the facial nerve) that results in inability to control facial muscles on the affected side with weakness of the muscles of facial expression and eye closure. This can either be present in unilateral or bilateral form. Evidence: TAS. Frequency: Occasional (HP:0040283). (ORPHA:370968)
- Severe intellectual disability (HP:0010864): Severe intellectual disability (ID) is defined as a type of ID characterized by severely sub-average adaptive functioning and intellectual functioning, with an intelligence quotient (IQ) the range of 20-34. Evidence: TAS. Frequency: Occasional (HP:0040283). (ORPHA:370968)
- Abnormality of the tongue muscle (HP:0040173). Evidence: TAS. Frequency: Occasional (HP:0040283). (ORPHA:370968)